- Vomiting (HP:0002013): Forceful ejection of the contents of the stomach through the mouth by means of a series of involuntary spasmic contractions. Evidence: IEA. (OMIM:157300)
- Migraine with aura (HP:0002077): A type of migraine in which there is an aura characterized by focal neurological phenomena that usually proceed, but may accompany or occur in the absence of, the headache. The symptoms of an aura may include fully reversible visual, sensory, and speech symptoms but not motor weakness. Visual symptoms may include flickering lights, spots and lines and/or loss of vision and/or unilateral sensory symptoms such as paresthesias or numbness. At least one of the symptoms of an aura develops gradually over 5 or more minutes and/or different symptoms occur in succession. Evidence: IEA. (OMIM:157300)
- Photophobia (HP:0000613): Excessive sensitivity to light with the sensation of discomfort or pain in the eyes due to exposure to bright light. Evidence: IEA. (OMIM:157300)
- Migraine without aura (HP:0002083): Repeated headache attacks lasting 4-72 h fulfilling at least two of the following criteria: 1) unilateral location, 2) pulsating quality, 3) moderate or severe pain intensity, and 4) aggravation by or causing avoidance of routine physical activity such as climbing stairs. Headache attacks are commonly accompanied by nausea, vomiting, photophobia, or phonophobia. Evidence: IEA. (OMIM:157300)
- Phonophobia (HP:0002183): An abnormally heightened sensitivity to loud sounds. Evidence: IEA. (OMIM:157300)
- Nausea (HP:0002018): A sensation of unease in the stomach together with an urge to vomit. Evidence: IEA. (OMIM:157300)
- Autosomal dominant inheritance (HP:0000006): A mode of inheritance that is observed for traits related to a gene encoded on one of the autosomes (i.e., the human chromosomes 1-22) in which a trait manifests in heterozygotes. In the context of medical genetics, an autosomal dominant disorder is caused when a single copy of the mutant allele is present. Males and females are affected equally, and can both transmit the disorder with a risk of 50% for each child of inheriting the mutant allele. Evidence: IEA. (OMIM:157300)
These phenotypes are associated with the disease migraine with or without aura, susceptibility to, 1 (OMIM:157300).